- Ocular hypertension (HP:0007906): Intraocular pressure that is 2 standard deviations above the population mean. Evidence: IEA. (OMIM:601682)
- Autosomal dominant inheritance (HP:0000006): A mode of inheritance that is observed for traits related to a gene encoded on one of the autosomes (i.e., the human chromosomes 1-22) in which a trait manifests in heterozygotes. In the context of medical genetics, an autosomal dominant disorder is caused when a single copy of the mutant allele is present. Males and females are affected equally, and can both transmit the disorder with a risk of 50% for each child of inheriting the mutant allele. Evidence: IEA. (OMIM:601682)
- Glaucoma (HP:0000501): Glaucoma refers loss of retinal ganglion cells in a characteristic pattern of optic neuropathy usually associated with increased intraocular pressure. Evidence: IEA. (OMIM:601682)
These phenotypes are associated with the disease glaucoma type 1C (OMIM:601682).